- Bronchoconstriction (HP:4000007): Tightening of smooth muscle surrounding the bronchi and bronchioles with consequent wheezing and shortness of breath. Evidence: TAS. Frequency: Very rare (HP:0040284). (ORPHA:100082)
- Carcinoid tumor (HP:0100570): A tumor formed from the endocrine (argentaffin) cells of the mucosal lining of a variety of organs including the stomach and intestine. These cells are from neuroectodermal origin. Evidence: TAS. Frequency: Obligate (HP:0040280). (ORPHA:100082)
- Weight loss (HP:0001824): Reduction of total body weight. Evidence: TAS. Frequency: Frequent (HP:0040282). (ORPHA:100082)
- Constipation (HP:0002019): Infrequent or difficult evacuation of feces. Evidence: TAS. Frequency: Frequent (HP:0040282). (ORPHA:100082)
- Abdominal pain (HP:0002027): An unpleasant sensation characterized by physical discomfort (such as pricking, throbbing, or aching) and perceived to originate in the abdomen. Evidence: TAS. Frequency: Frequent (HP:0040282). (ORPHA:100082)
- Chronic noninfectious lymphadenopathy (HP:0002730): A chronic form of lymphadenopathy that is not related to infection. Evidence: TAS. Frequency: Frequent (HP:0040282). (ORPHA:100082)
- Elevated circulating hepatic transaminase concentration (HP:0002910): Elevations of the levels of SGOT and SGPT in the serum. SGOT (serum glutamic oxaloacetic transaminase) and SGPT (serum glutamic pyruvic transaminase) are transaminases primarily found in the liver and heart and are released into the bloodstream as the result of liver or heart damage. SGOT and SGPT are used clinically mainly as markers of liver damage. Evidence: TAS. Frequency: Frequent (HP:0040282). (ORPHA:100082)
- Tenesmus (HP:0012702): A repeated, painful urge to defecate without excreting stool. Evidence: TAS. Frequency: Frequent (HP:0040282). (ORPHA:100082)
- Bloody diarrhea (HP:0025085): Passage of many stools containing blood. Evidence: TAS. Frequency: Frequent (HP:0040282). (ORPHA:100082)
- Hypoactive bowel sounds (HP:0030144): An decreased amount of bowel sounds. Evidence: TAS. Frequency: Frequent (HP:0040282). (ORPHA:100082)
- Atypical pulmonary carcinoid tumor (HP:0030446). Evidence: TAS. Frequency: Frequent (HP:0040282). (ORPHA:100082)
- Right ventricular failure (HP:0001708): Reduced ability of the right ventricle to perform its function (to receive blood from the right atrium and to eject blood into the pulmonary artery), often leading to pitting peripheral edema, ascites, and hepatomegaly. Evidence: TAS. Frequency: Very rare (HP:0040284). (ORPHA:100082)
- Palpitations (HP:0001962): A sensation that the heart is pounding or racing, which is a non-specific sign but may be a manifestation of arrhythmia. Evidence: TAS. Frequency: Very rare (HP:0040284). (ORPHA:100082)
- Melena (HP:0002249): The passage of blackish, tarry feces associated with gastrointestinal hemorrhage. Melena occurs if the blood remains in the colon long enough for it to be broken down by colonic bacteria. One degradation product, hematin, imbues the stool with a blackish color. Thus, melena generally occurs with bleeding from the upper gastrointestinal tract (e.g., stomach ulcers or duodenal ulcers), since the blood usually remains in the gut for a longer period of time than with lower gastrointestinal bleeding. Evidence: TAS. Frequency: Very rare (HP:0040284). (ORPHA:100082)
- Hypotension (HP:0002615): Low Blood Pressure, vascular hypotension. Evidence: TAS. Frequency: Very rare (HP:0040284). (ORPHA:100082)
- Increased serum serotonin (HP:0003144): A increased concentration of serotonin in the blood. Evidence: TAS. Frequency: Very rare (HP:0040284). (ORPHA:100082)
- Protracted diarrhea (HP:0004385). Evidence: TAS. Frequency: Very rare (HP:0040284). (ORPHA:100082)
- Tricuspid regurgitation (HP:0005180): Failure of the tricuspid valve to close sufficiently upon contraction of the right ventricle, causing blood to regurgitate (flow backward) into the right atrium. Evidence: TAS. Frequency: Very rare (HP:0040284). (ORPHA:100082)
- Facial telangiectasia (HP:0007380): Telangiectases (small dilated blood vessels) located near the surface of the skin of the face. Evidence: TAS. Frequency: Very rare (HP:0040284). (ORPHA:100082)
- Bowel urgency (HP:0012701): A sudden, irresistible need to have a bowel movement. Evidence: TAS. Frequency: Very rare (HP:0040284). (ORPHA:100082)
- Lack of bowel sounds (HP:0030145): Complete lack of abdominal sounds as assayed by examination of the abdomen with a stethoscope. Evidence: TAS. Frequency: Very rare (HP:0040284). (ORPHA:100082)
- Abnormal pulmonary valve cusp morphology (HP:0031566): Any structural anomaly of the pulmonary valve leaflets. Evidence: TAS. Frequency: Very rare (HP:0040284). (ORPHA:100082)
- Anorexia (HP:0002039): Lack of desire to eat (loss of appetite). Evidence: TAS. Frequency: Frequent (HP:0040282). (ORPHA:100082)
- Hepatomegaly (HP:0002240): Abnormally increased size of the liver. Evidence: TAS. Frequency: Frequent (HP:0040282). (ORPHA:100082)
- Hematochezia (HP:0002573): The passage of fresh (red) blood per anus, usually in or with stools. Most rectal bleeding comes from the colon, rectum, or anus. Evidence: TAS. Frequency: Frequent (HP:0040282). (ORPHA:100082)
These phenotypes are associated with the disease Neuroendocrine tumor of anal canal (ORPHA:100082).